- Muscle weakness (HP:0001324): Reduced strength of muscles. Evidence: TAS. Frequency: Very frequent (HP:0040281). (ORPHA:2912)
- Pain (HP:0012531): An unpleasant sensory and emotional experience associated with actual or potential tissue damage, or described in terms of such damage. Evidence: TAS. Frequency: Very frequent (HP:0040281). (ORPHA:2912)
- Areflexia (HP:0001284): Absence of neurologic reflexes such as the knee-jerk reaction. Evidence: TAS. Frequency: Frequent (HP:0040282). (ORPHA:2912)
- Meningitis (HP:0001287): Inflammation of the meninges. Evidence: TAS. Frequency: Frequent (HP:0040282). (ORPHA:2912)
- Brisk reflexes (HP:0001348): Tendon reflexes that are noticeably more active than usual (conventionally denoted 3+ on clinical examination). Brisk reflexes may or may not indicate a neurological lesion. They are distinguished from hyperreflexia by the fact that hyerreflexia is characterized by hyperactive repeating (clonic) reflexes, which are considered to be always abnormal. Evidence: TAS. Frequency: Frequent (HP:0040282). (ORPHA:2912)
- Fever (HP:0001945): Body temperature elevated above the normal range. Evidence: TAS. Frequency: Frequent (HP:0040282). (ORPHA:2912)
- Vomiting (HP:0002013): Forceful ejection of the contents of the stomach through the mouth by means of a series of involuntary spasmic contractions. Evidence: TAS. Frequency: Frequent (HP:0040282). (ORPHA:2912)
- Nausea (HP:0002018): A sensation of unease in the stomach together with an urge to vomit. Evidence: TAS. Frequency: Frequent (HP:0040282). (ORPHA:2912)
- Anorexia (HP:0002039): Lack of desire to eat (loss of appetite). Evidence: TAS. Frequency: Frequent (HP:0040282). (ORPHA:2912)
- Headache (HP:0002315): Cephalgia, or pain sensed in various parts of the head, not confined to the area of distribution of any nerve. Evidence: TAS. Frequency: Frequent (HP:0040282). (ORPHA:2912)
- Arthralgia (HP:0002829): Joint pain. Evidence: TAS. Frequency: Frequent (HP:0040282). (ORPHA:2912)
- Skeletal muscle atrophy (HP:0003202): The presence of skeletal muscular atrophy (which is also known as amyotrophy). Evidence: TAS. Frequency: Frequent (HP:0040282). (ORPHA:2912)
- Myalgia (HP:0003326): Pain in muscle. Evidence: TAS. Frequency: Frequent (HP:0040282). (ORPHA:2912)
- Paralysis (HP:0003470): Paralysis of voluntary muscles means loss of contraction due to interruption of one or more motor pathways from the brain to the muscle fibers. Although the word paralysis is often used interchangeably to mean either complete or partial loss of muscle strength, it is preferable to use paralysis or plegia for complete or severe loss of muscle strength, and paresis for partial or slight loss. Motor paralysis results from deficits of the upper motor neurons (corticospinal, corticobulbar, or subcorticospinal). Motor paralysis is often accompanied by an impairment in the facility of movement. Evidence: TAS. Frequency: Frequent (HP:0040282). (ORPHA:2912)
- Exercise intolerance (HP:0003546): A functional motor deficit where individuals whose responses to the challenges of exercise fail to achieve levels considered normal for their age and gender. Evidence: TAS. Frequency: Frequent (HP:0040282). (ORPHA:2912)
- Functional motor deficit (HP:0004302). Evidence: TAS. Frequency: Frequent (HP:0040282). (ORPHA:2912)
- Lower limb muscle weakness (HP:0007340): Weakness of the muscles of the legs. Evidence: TAS. Frequency: Frequent (HP:0040282). (ORPHA:2912)
- Hypoplasia of the musculature (HP:0009004): Underdevelopment of the musculature. Evidence: TAS. Frequency: Frequent (HP:0040282). (ORPHA:2912)
- Muscle flaccidity (HP:0010547): A type of paralysis in which a muscle becomes soft and yields to passive stretching, which results from loss of all or practically all peripheral motor nerves that innervated the muscle. Muscle tone is reduced and the affected muscles undergo extreme atrophy within months of the loss of innervation. Evidence: TAS. Frequency: Frequent (HP:0040282). (ORPHA:2912)
- Abnormal skeletal muscle morphology (HP:0011805): A structural abnormality of a skeletal muscle. Evidence: TAS. Frequency: Frequent (HP:0040282). (ORPHA:2912)
- Fatigue (HP:0012378): A subjective feeling of tiredness characterized by a lack of energy and motivation. Evidence: TAS. Frequency: Frequent (HP:0040282). (ORPHA:2912)
- Myelitis (HP:0012486): Inflammation of the spinal cord. Evidence: TAS. Frequency: Frequent (HP:0040282). (ORPHA:2912)
- Stiff neck (HP:0025258): A sensation of tightness in the neck when attempting to move it, especially after a period of inactivity. Neck stiffness often involves soreness and difficulty moving the neck, especially when trying to turn the head to the side. Evidence: TAS. Frequency: Frequent (HP:0040282). (ORPHA:2912)
- Pharyngitis (HP:0025439): Inflammation (due to infection or irritation) of the pharynx. Evidence: TAS. Frequency: Frequent (HP:0040282). (ORPHA:2912)
- Low self-esteem (HP:0031469): Persistent, excessively negative, and critical thoughts of one's personal abilities, attributes, or any feature related to the self and self-attitude. The affected individual believes they are a lesser being compared to others in their social peer group. Evidence: TAS. Frequency: Frequent (HP:0040282). (ORPHA:2912)
- Abnormal motor nerve conduction velocity (HP:0040131). Evidence: TAS. Frequency: Frequent (HP:0040282). (ORPHA:2912)
- Bulbar palsy (HP:0001283): Bulbar weakness (or bulbar palsy) refers to bilateral impairment of function of the lower cranial nerves IX, X, XI and XII, which occurs due to lower motor neuron lesion either at nuclear or fascicular level in the medulla or from bilateral lesions of the lower cranial nerves outside the brain-stem. Bulbar weakness is often associated with difficulty in chewing, weakness of the facial muscles, dysarthria, palatal weakness and regurgitation of fluids, dysphagia, and dysphonia. Evidence: TAS. Frequency: Occasional (HP:0040283). (ORPHA:2912)
- Dysphonia (HP:0001618): Difficulty in speaking due to a physical disorder of the mouth, tongue, throat, or vocal cords. Associated with a known physical or neurological cause. Evidence: TAS. Frequency: Occasional (HP:0040283). (ORPHA:2912)
- Dysphagia (HP:0002015): Difficulty in swallowing. Evidence: TAS. Frequency: Occasional (HP:0040283). (ORPHA:2912)
- Diminished movement (HP:0002374). Evidence: TAS. Frequency: Occasional (HP:0040283). (ORPHA:2912)
- Fasciculations (HP:0002380): Fasciculations are observed as small, local, involuntary muscle contractions (twitching) visible under the skin. Fasciculations result from increased irritability of an axon (which in turn is often a manifestation of disease of a motor neuron). This leads to sporadic discharges of all the muscle fibers controlled by the axon in isolation from other motor units. Evidence: TAS. Frequency: Occasional (HP:0040283). (ORPHA:2912)
- Paraparesis (HP:0002385): Weakness or partial paralysis in the lower limbs. Evidence: TAS. Frequency: Occasional (HP:0040283). (ORPHA:2912)
- Bulbar signs (HP:0002483). Evidence: TAS. Frequency: Occasional (HP:0040283). (ORPHA:2912)
- Hyperkinetic movements (HP:0002487): Motor hyperactivity with excessive movement of muscles of the body as a whole. Evidence: TAS. Frequency: Occasional (HP:0040283). (ORPHA:2912)
- Inability to walk (HP:0002540): Incapability to ambulate. Evidence: TAS. Frequency: Occasional (HP:0040283). (ORPHA:2912)
- Paralytic ileus (HP:0002590). Evidence: TAS. Frequency: Occasional (HP:0040283). (ORPHA:2912)
- Immunodeficiency (HP:0002721): Failure of the immune system to protect the body adequately from infection, due to the absence or insufficiency of some component process or substance. Evidence: TAS. Frequency: Occasional (HP:0040283). (ORPHA:2912)
- Respiratory failure (HP:0002878): A severe form of respiratory insufficiency characterized by inadequate gas exchange such that the levels of oxygen or carbon dioxide cannot be maintained within normal limits. Evidence: TAS. Frequency: Occasional (HP:0040283). (ORPHA:2912)
- Paresthesia (HP:0003401): Abnormal sensations such as tingling, pricking, or numbness of the skin with no apparent physical cause. Evidence: TAS. Frequency: Occasional (HP:0040283). (ORPHA:2912)
- Upper limb muscle weakness (HP:0003484): Weakness of the muscles of the arms. Evidence: TAS. Frequency: Occasional (HP:0040283). (ORPHA:2912)
- Respiratory failure requiring assisted ventilation (HP:0004887): A state of respiratory distress that requires a life saving intervention in the form of gaining airway access and instituting positive pressure ventilation. Evidence: TAS. Frequency: Occasional (HP:0040283). (ORPHA:2912)
- Cranial nerve paralysis (HP:0006824). Evidence: TAS. Frequency: Occasional (HP:0040283). (ORPHA:2912)
- Fatigable weakness of respiratory muscles (HP:0030196): A type of weakness of the muscles involved in breathing (respiration) that occurs after a muscle group is used and lessens if the muscle group has some rest. That is, there is diminution of strength with repetitive muscle actions. Evidence: TAS. Frequency: Occasional (HP:0040283). (ORPHA:2912)
- Absent tonsils (HP:0030813): Lack of observable tonsillar tissue. Evidence: TAS. Frequency: Occasional (HP:0040283). (ORPHA:2912)
- Impairment of activities of daily living (HP:0031058): Difficulty in performing one or more activities normally performed every day, such as eating, bathing, dressing, grooming, work, homemaking, and leisure. Evidence: TAS. Frequency: Occasional (HP:0040283). (ORPHA:2912)
- Agitation (HP:0000713): A state of excessive motor activity that is associated with mental distress or a feeling of substantial unease or inner tension. Distinguished from restlessness by the increased level of emotional distress and negative intensity of the experience. Agitation has a significant level of physical activity that is typically threatening to the self or others. Evidence: TAS. Frequency: Very rare (HP:0040284). (ORPHA:2912)
- Irritability (HP:0000737): An emotional state characterized by negative feelings of heightened frustration, annoyance, or feeling upset, often triggered by internal factors (e.g., fatigue, hunger, unfulfilled desires) or external factors (e.g., social or environmental challenges). Irritability may be unpredictable, and is accompanied by a lowered threshold for emotional reactivity and observable features (speech, facial expressions, or psychomotor activity). Evidence: TAS. Frequency: Very rare (HP:0040284). (ORPHA:2912)
- Hypertension (HP:0000822): The presence of chronic increased pressure in the systemic arterial system. Evidence: TAS. Frequency: Very rare (HP:0040284). (ORPHA:2912)
- Coma (HP:0001259): The complete absence of wakefulness and consciousness, which is evident through a lack of response to any form of external stimuli. Evidence: TAS. Frequency: Very rare (HP:0040284). (ORPHA:2912)
- Confusion (HP:0001289): Lack of clarity and coherence of thought, perception, understanding, or action. Evidence: TAS. Frequency: Very rare (HP:0040284). (ORPHA:2912)
- Infectious encephalitis (HP:0002383): A disorder of the brain caused by an infectious agent that presents with fever, headache, and an altered level of consciousness. There may also be focal or multifocal neurologic deficits, and focal or generalized seizure activity. Evidence: TAS. Frequency: Very rare (HP:0040284). (ORPHA:2912)
- Hypotension (HP:0002615): Low Blood Pressure, vascular hypotension. Evidence: TAS. Frequency: Very rare (HP:0040284). (ORPHA:2912)
- Hypovolemic shock (HP:0031274): A state of shock characterized by decreased circulating blood volume in relation to total vascular capacity. This type of shock is characterized by a reduction of diastolic filling pressures. Evidence: TAS. Frequency: Very rare (HP:0040284). (ORPHA:2912)
These phenotypes are associated with the disease Poliomyelitis (ORPHA:2912).